- Carnosinuria (HP:0003167): An increased concentration of carnosine in the urine. Evidence: IEA. (OMIM:212200)
- Generalized myoclonic seizure (HP:0002123): A generalized myoclonic seizure is a type of generalized motor seizure characterized by bilateral, sudden, brief (<100 ms) involuntary single or multiple contraction of muscles or muscle groups of variable topography (axial, proximal limb, distal). Myoclonus is less regularly repetitive and less sustained than is clonus. Evidence: IEA. (OMIM:212200)
- Autosomal recessive inheritance (HP:0000007): A mode of inheritance that is observed for traits related to a gene encoded on one of the autosomes (i.e., the human chromosomes 1-22) in which a trait manifests in individuals with two pathogenic alleles, either homozygotes (two copies of the same mutant allele) or compound heterozygotes (whereby each copy of a gene has a distinct mutant allele). Evidence: IEA. (OMIM:212200)
- Intellectual disability (HP:0001249): The term intellectual disability or intellectual developmental disorder is used to describe significantly sub-average intellectual and adaptive functioning based on clinical assessment and as measured by individually administered, appropriately normed, standardized and validated tests of intellectual functioning and adaptive behavior, with onset during the developmental period from infancy through adolescence. Evidence: IEA. (OMIM:212200)
These phenotypes are associated with the disease carnosinemia (OMIM:212200).